Phenotypes associated with the disease Xq25 microduplication syndrome (ORPHA:521258):
- Malar flattening (HP:0000272): Underdevelopment of the malar prominence of the jugal bone (zygomatic bone in mammals), appreciated in profile, frontal view, and/or by palpation. Evidence: TAS. Frequency: Frequent (HP:0040282). (ORPHA:521258)
- Epicanthus (HP:0000286): A fold of skin starting above the medial aspect of the upper eyelid and arching downward to cover, pass in front of and lateral to the medial canthus. Evidence: TAS. Frequency: Frequent (HP:0040282). (ORPHA:521258)
- Facial hypotonia (HP:0000297): Reduced muscle tone of a muscle that is innervated by the facial nerve (the seventh cranial nerve). Evidence: TAS. Frequency: Frequent (HP:0040282). (ORPHA:521258)
- Mandibular prognathia (HP:0000303): Abnormal prominence of the chin related to increased length of the mandible. Evidence: TAS. Frequency: Frequent (HP:0040282). (ORPHA:521258)
- Autistic behavior (HP:0000729): Persistent deficits in social interaction and communication and interaction as well as a markedly restricted repertoire of activity and interest as well as repetitive patterns of behavior. Evidence: TAS. Frequency: Frequent (HP:0040282). (ORPHA:521258)
- Anxiety (HP:0000739): Intense feelings of nervousness, tension, or panic often arise in response to interpersonal stresses. There is worry about the negative effects of past unpleasant experiences and future negative possibilities. Individuals may feel fearful, apprehensive, or threatened by uncertainty, and they may also have fears of falling apart or losing control. Evidence: TAS. Frequency: Frequent (HP:0040282). (ORPHA:521258)
- Hyperactivity (HP:0000752): Hyperactivity is a condition characterized by constant and unusually high levels of activity, even in situations where it is deemed inappropriate. Evidence: TAS. Frequency: Frequent (HP:0040282). (ORPHA:521258)
- Seizure (HP:0001250): A seizure is an intermittent abnormality of nervous system physiology characterized by a transient occurrence of signs and/or symptoms due to abnormal excessive or synchronous neuronal activity in the brain. Evidence: TAS. Frequency: Frequent (HP:0040282). (ORPHA:521258)
- Global developmental delay (HP:0001263): A delay in the achievement of motor or mental milestones in the domains of development of a child, including motor skills, speech and language, cognitive skills, and social and emotional skills. This term should only be used to describe children younger than five years of age. Evidence: TAS. Frequency: Frequent (HP:0040282). (ORPHA:521258)
- Generalized hypotonia (HP:0001290): Generalized muscular hypotonia (abnormally low muscle tone). Evidence: TAS. Frequency: Frequent (HP:0040282). (ORPHA:521258)
- Cerebellar hypoplasia (HP:0001321): Cerebellar hypoplasia is a descriptive term implying a cerebellum with a reduced volume, but a normal shape and is stable over time. Evidence: TAS. Frequency: Frequent (HP:0040282). (ORPHA:521258)
- Hypoplasia of the corpus callosum (HP:0002079): Underdevelopment of the corpus callosum. Evidence: TAS. Frequency: Frequent (HP:0040282). (ORPHA:521258)
- Moderate intellectual disability (HP:0002342): Moderate intellectual disability (ID) is defined as a type of ID characterized by moderately sub-average adaptive functioning and intellectual functioning, with an intelligence quotient (IQ) the range of 35-49. Evidence: TAS. Frequency: Frequent (HP:0040282). (ORPHA:521258)
- Sleep disturbance (HP:0002360): An abnormal pattern in the quality, quantity, or characteristics of sleep. Evidence: TAS. Frequency: Frequent (HP:0040282). (ORPHA:521258)
- Highly arched eyebrow (HP:0002553): Increased height of the central portion of the eyebrow, forming a crescent, semicircular, or inverted U shape. Evidence: TAS. Frequency: Frequent (HP:0040282). (ORPHA:521258)
- Abnormality of the palpebral fissures (HP:0008050): An anomaly of the space between the medial and lateral canthi of the two open eyelids. Evidence: TAS. Frequency: Frequent (HP:0040282). (ORPHA:521258)
- Speech articulation difficulties (HP:0009088): Impairment in the physical production of speech sounds. Evidence: TAS. Frequency: Frequent (HP:0040282). (ORPHA:521258)
- Thick vermilion border (HP:0012471): Increased width of the skin of vermilion border region of upper lip. Evidence: TAS. Frequency: Frequent (HP:0040282). (ORPHA:521258)
- Sparse eyebrow (HP:0045075): Decreased density/number of eyebrow hairs. Evidence: TAS. Frequency: Frequent (HP:0040282). (ORPHA:521258)
- Short stature (HP:0004322): A height below that which is expected according to age and gender norms. Although there is no universally accepted definition of short stature, many refer to "short stature" as height more than 2 standard deviations below the mean for age and gender (or below the 3rd percentile for age and gender dependent norms). Evidence: TAS. Frequency: Occasional (HP:0040283). (ORPHA:521258)